Phenotypes associated with the disease sodium-potassium-ATPase activity of red cell (OMIM:270425):
- Abnormality of metabolism/homeostasis (HP:0001939). Evidence: IEA. (OMIM:270425)
- Autosomal recessive inheritance (HP:0000007): A mode of inheritance that is observed for traits related to a gene encoded on one of the autosomes (i.e., the human chromosomes 1-22) in which a trait manifests in individuals with two pathogenic alleles, either homozygotes (two copies of the same mutant allele) or compound heterozygotes (whereby each copy of a gene has a distinct mutant allele). Evidence: TAS. (OMIM:270425)